Phenotypes associated with the disease Bronchial neuroendocrine tumor (ORPHA:97287):
- Bronchoconstriction (HP:4000007): Tightening of smooth muscle surrounding the bronchi and bronchioles with consequent wheezing and shortness of breath. Evidence: TAS. Frequency: Very rare (HP:0040284). (ORPHA:97287)
- Pulmonary carcinoid tumor (HP:0030445): A malignant neuroendocrine tumor of the lung. According to histopathologic criteria (WHO 2004), carcinoids are divided into four groups i.e. typical and atypical carcinoids, large cell neuroendocrine carcinoma and small cell lung carcinoma. Evidence: TAS. Frequency: Obligate (HP:0040280). (ORPHA:97287)
- Weight loss (HP:0001824): Reduction of total body weight. Evidence: TAS. Frequency: Frequent (HP:0040282). (ORPHA:97287)
- Anorexia (HP:0002039): Lack of desire to eat (loss of appetite). Evidence: TAS. Frequency: Frequent (HP:0040282). (ORPHA:97287)
- Pneumonia (HP:0002090): Inflammation of any part of the lung parenchyma. Evidence: TAS. Frequency: Frequent (HP:0040282). (ORPHA:97287)
- Dyspnea (HP:0002094): Difficult or labored breathing. Dyspnea is a subjective feeling only the patient can rate, e.g., on a Borg scale. Evidence: TAS. Frequency: Frequent (HP:0040282). (ORPHA:97287)
- Asthma (HP:0002099): Asthma is characterized by increased responsiveness of the tracheobronchial tree to multiple stimuli, leading to narrowing of the air passages with resultant dyspnea, cough, and wheezing. Evidence: TAS. Frequency: Frequent (HP:0040282). (ORPHA:97287)
- Hemoptysis (HP:0002105): Coughing up (expectoration) of blood or blood-streaked sputum from the larynx, trachea, bronchi, or lungs. Evidence: TAS. Frequency: Frequent (HP:0040282). (ORPHA:97287)
- Chronic noninfectious lymphadenopathy (HP:0002730): A chronic form of lymphadenopathy that is not related to infection. Evidence: TAS. Frequency: Frequent (HP:0040282). (ORPHA:97287)
- Poor appetite (HP:0004396): A reduced desire to eat. Evidence: TAS. Frequency: Frequent (HP:0040282). (ORPHA:97287)
- Abnormal pulmonary interstitial morphology (HP:0006530): Abnormality of the lung parenchyma extending to the pulmonary interstitium and leading to diffuse pulmonary fibrosis. Evidence: TAS. Frequency: Frequent (HP:0040282). (ORPHA:97287)
- Wheezing (HP:0030828): A high-pitched whistling sound associated with labored breathing. Evidence: TAS. Frequency: Frequent (HP:0040282). (ORPHA:97287)
- Nonproductive cough (HP:0031246): A cough that does not produce phlegm or mucus. Evidence: TAS. Frequency: Frequent (HP:0040282). (ORPHA:97287)
- Chest pain (HP:0100749): An unpleasant sensation characterized by physical discomfort (such as pricking, throbbing, or aching) localized to the chest. Evidence: TAS. Frequency: Frequent (HP:0040282). (ORPHA:97287)
- Elevated circulating growth hormone concentration (HP:0000845): Acromegaly is a condition resulting from overproduction of growth hormone by the pituitary gland in persons with closed epiphyses, and consists chiefly in the enlargement of the distal parts of the body. The circumference of the skull increases, the nose becomes broad, the tongue becomes enlarged, the facial features become coarsened, the mandible grows excessively, and the teeth become separated. The fingers and toes grow chiefly in thickness. Evidence: TAS. Frequency: Very rare (HP:0040284). (ORPHA:97287)
- Dermatological manifestations of systemic disorders (HP:0001005). Evidence: TAS. Frequency: Very rare (HP:0040284). (ORPHA:97287)
- Hepatic failure (HP:0001399). Evidence: TAS. Frequency: Very rare (HP:0040284). (ORPHA:97287)
- Right ventricular failure (HP:0001708): Reduced ability of the right ventricle to perform its function (to receive blood from the right atrium and to eject blood into the pulmonary artery), often leading to pitting peripheral edema, ascites, and hepatomegaly. Evidence: TAS. Frequency: Very rare (HP:0040284). (ORPHA:97287)
- Palpitations (HP:0001962): A sensation that the heart is pounding or racing, which is a non-specific sign but may be a manifestation of arrhythmia. Evidence: TAS. Frequency: Very rare (HP:0040284). (ORPHA:97287)
- Hepatomegaly (HP:0002240): Abnormally increased size of the liver. Evidence: TAS. Frequency: Very rare (HP:0040284). (ORPHA:97287)
- Hypotension (HP:0002615): Low Blood Pressure, vascular hypotension. Evidence: TAS. Frequency: Very rare (HP:0040284). (ORPHA:97287)
- Increased circulating cortisol level (HP:0003118): Overproduction of the hormone of cortisol by the adrenal cortex, resulting in a characteristic combination of clinical symptoms termed Cushing syndrome, with truncal obesity, a round, full face, striae atrophicae and acne, muscle weakness, and other features. Evidence: TAS. Frequency: Very rare (HP:0040284). (ORPHA:97287)
- Increased serum serotonin (HP:0003144): A increased concentration of serotonin in the blood. Evidence: TAS. Frequency: Very rare (HP:0040284). (ORPHA:97287)
- Increased circulating ACTH level (HP:0003154): An abnormal increased in the concentration of corticotropin, also known as adrenocorticotropic hormone (ACTH), in the blood. Evidence: TAS. Frequency: Very rare (HP:0040284). (ORPHA:97287)
- Protracted diarrhea (HP:0004385). Evidence: TAS. Frequency: Very rare (HP:0040284). (ORPHA:97287)
- Tricuspid regurgitation (HP:0005180): Failure of the tricuspid valve to close sufficiently upon contraction of the right ventricle, causing blood to regurgitate (flow backward) into the right atrium. Evidence: TAS. Frequency: Very rare (HP:0040284). (ORPHA:97287)
- Facial telangiectasia (HP:0007380): Telangiectases (small dilated blood vessels) located near the surface of the skin of the face. Evidence: TAS. Frequency: Very rare (HP:0040284). (ORPHA:97287)
- Bowel urgency (HP:0012701): A sudden, irresistible need to have a bowel movement. Evidence: TAS. Frequency: Very rare (HP:0040284). (ORPHA:97287)
- Cardiogenic shock (HP:0030149): Severely decreased cardiac output with evidence of inadequate end-organ perfusion (i.e., tissue hypoxia) in the presence of adequate intravascular volume. Evidence: TAS. Frequency: Very rare (HP:0040284). (ORPHA:97287)
- Night sweats (HP:0030166): Occurrence of excessive sweating during sleep. Evidence: TAS. Frequency: Very rare (HP:0040284). (ORPHA:97287)
- Abnormal pulmonary valve cusp morphology (HP:0031566): Any structural anomaly of the pulmonary valve leaflets. Evidence: TAS. Frequency: Very rare (HP:0040284). (ORPHA:97287)